- Cutaneous melanoma (HP:0012056): The presence of a melanoma of the skin. Evidence: PCS. (PMID:22080950)
- Autosomal dominant inheritance (HP:0000006): A mode of inheritance that is observed for traits related to a gene encoded on one of the autosomes (i.e., the human chromosomes 1-22) in which a trait manifests in heterozygotes. In the context of medical genetics, an autosomal dominant disorder is caused when a single copy of the mutant allele is present. Males and females are affected equally, and can both transmit the disorder with a risk of 50% for each child of inheriting the mutant allele. Evidence: PCS. (PMID:22080950)
These phenotypes are associated with the disease melanoma, cutaneous malignant, susceptibility to, 8 (OMIM:614456).